- Abnormality of metabolism/homeostasis (HP:0001939). Evidence: IEA. (OMIM:194470)
- Autosomal dominant inheritance (HP:0000006): A mode of inheritance that is observed for traits related to a gene encoded on one of the autosomes (i.e., the human chromosomes 1-22) in which a trait manifests in heterozygotes. In the context of medical genetics, an autosomal dominant disorder is caused when a single copy of the mutant allele is present. Males and females are affected equally, and can both transmit the disorder with a risk of 50% for each child of inheriting the mutant allele. Evidence: IEA. (OMIM:194470)
These phenotypes are associated with the disease Zinc, elevated plasma (OMIM:194470).